Phenotypes associated with the disease X-linked intellectual disability-cardiomegaly-congestive heart failure syndrome (OMIM:300886):
- Kyphoscoliosis (HP:0002751): An abnormal curvature of the spine in both a coronal (lateral) and sagittal (back-to-front) plane. Evidence: PCS. Frequency: 1/2. (PMID:22814392)
- Spastic tetraplegia (HP:0002510): Spastic paralysis affecting all four limbs. Evidence: PCS. Frequency: 1/2. (PMID:22814392)
- Absent speech (HP:0001344): Complete lack of development of speech and language abilities. Evidence: PCS. Frequency: 1/2. (PMID:22814392)
- Cardiomegaly (HP:0001640): Increased size of the heart, clinically defined as an increased transverse diameter of the cardiac silhouette that is greater than or equal to 50% of the transverse diameter of the chest (increased cardiothoracic ratio) on a posterior-anterior projection of a chest radiograph or a computed tomography. Evidence: PCS. Frequency: 2/2. Onset: Middle age onset (HP:0003596). (PMID:22814392)
- Seizure (HP:0001250): A seizure is an intermittent abnormality of nervous system physiology characterized by a transient occurrence of signs and/or symptoms due to abnormal excessive or synchronous neuronal activity in the brain. Evidence: PCS. Frequency: 2/2. (PMID:22814392)
- Profound intellectual disability (HP:0002187): Profound intellectual disability (ID) is defined as a type of ID characterized by profoundly sub-average adaptive functioning and intellectual functioning, with an intelligence quotient (IQ) below 20. Evidence: PCS. Frequency: 2/2. (PMID:22814392)
- Global developmental delay (HP:0001263): A delay in the achievement of motor or mental milestones in the domains of development of a child, including motor skills, speech and language, cognitive skills, and social and emotional skills. This term should only be used to describe children younger than five years of age. Evidence: PCS. Frequency: 2/2. (PMID:22814392)
- Macroorchidism (HP:0000053): The presence of abnormally large testes. Evidence: PCS. Frequency: 2/2. (PMID:22814392)
- X-linked recessive inheritance (HP:0001419): A mode of inheritance that is observed for recessive traits related to a gene encoded on the X chromosome. In the context of medical genetics, X-linked recessive disorders manifest in males (who have one copy of the X chromosome and are thus hemizygotes), but generally not in female heterozygotes who have one mutant and one normal allele. Evidence: PCS. (PMID:22814392)
- Hydrocephalus (HP:0000238): Hydrocephalus is an active distension of the ventricular system of the brain resulting from inadequate passage of CSF from its point of production within the cerebral ventricles to its point of absorption into the systemic circulation. Evidence: PCS. Frequency: 1/2. (PMID:22814392)
- Congestive heart failure (HP:0001635): The presence of an abnormality of cardiac function that is responsible for the failure of the heart to pump blood at a rate that is commensurate with the needs of the tissues or a state in which abnormally elevated filling pressures are required for the heart to do so. Heart failure is frequently related to a defect in myocardial contraction. Evidence: PCS. Frequency: 2/2. Onset: Middle age onset (HP:0003596). (PMID:22814392)
- Macrotia (HP:0000400): Median longitudinal ear length greater than two standard deviations above the mean and median ear width greater than two standard deviations above the mean (objective); or, apparent increase in length and width of the pinna (subjective). Evidence: PCS. Frequency: 2/2. (PMID:22814392)
- Macrocephaly (HP:0000256): Occipitofrontal (head) circumference greater than 97th centile compared to appropriate, age matched, sex-matched normal standards. Alternatively, a apparently increased size of the cranium. Evidence: PCS. Frequency: 1/2. (PMID:22814392)